Phenotypes associated with the disease arthrogryposis, Perthes disease, and upward gaze palsy (OMIM:614262):
- Upgaze palsy (HP:0025331): A limitation of the ability to direct one's gaze above the horizontal meridian. Evidence: PCS. Frequency: 3/3. (PMID:26633546)
- Avascular necrosis of the capital femoral epiphysis (HP:0005743): Avascular necrosis of the proximal epiphysis of the femur occurring in growing children and caused by an interruption of the blood supply to the head of the femur close to the hip joint. The necrosis is characteristically associated with flattening of the femoral head, for which reason the term coxa plana has been used to refer to this feature in the medical literature. Evidence: PCS. Frequency: 3/3. (PMID:26633546)
- Congenital onset (HP:0003577): A phenotypic abnormality that is present at birth. Evidence: PCS. Frequency: 3/3. (PMID:26633546)
- Atopic dermatitis (HP:0001047): Atopic dermatitis (AD) or atopic eczema is an itchy, inflammatory skin condition with a predilection for the skin flexures. It is characterized by poorly defined erythema with edema, vesicles, and weeping in the acute stage and skin thickening (lichenification) in the chronic stage. Evidence: TAS. (OMIM:614262)
- Pyloric stenosis (HP:0002021): Pyloric stenosis, also known as infantile hypertrophic pyloric stenosis, is an uncommon condition in infants characterized by abnormal thickening of the pylorus muscles in the stomach leading to gastric outlet obstruction. Clinically infants are well at birth. Then, at 3 to 6 weeks of age, the infants present with projectile vomiting, potentially leading to dehydration and weight loss. Evidence: PCS. Frequency: 2/3. (PMID:26633546)
- Full cheeks (HP:0000293): Increased prominence or roundness of soft tissues between zygomata and mandible. Evidence: TAS. (OMIM:614262)
- Asthma (HP:0002099): Asthma is characterized by increased responsiveness of the tracheobronchial tree to multiple stimuli, leading to narrowing of the air passages with resultant dyspnea, cough, and wheezing. Evidence: PCS. Frequency: 3/3. (PMID:26633546)
- Camptodactyly (HP:0012385): The distal interphalangeal joint and/or the proximal interphalangeal joint of the fingers or toes cannot be extended to 180 degrees by either active or passive extension. Evidence: PCS. Frequency: 2/3. (PMID:26633546)
- Ventricular septal defect (HP:0001629): A hole between the two bottom chambers (ventricles) of the heart. The defect is centered around the most superior aspect of the ventricular septum. Evidence: PCS. Frequency: 1/3. (PMID:26633546)
- Overlapping toe (HP:0001845): Describes a foot digit resting on the dorsal surface of an adjacent digit when the foot is at rest. Initially clawing may be dynamic and only noticeable on walking. Over time the plantar plate tears, subluxation occurs at the metatarsophalangeal joint (MTPJ), and the deformity becomes permanent. Evidence: PCS. Frequency: 1/3. (PMID:26633546)
- Autosomal recessive inheritance (HP:0000007): A mode of inheritance that is observed for traits related to a gene encoded on one of the autosomes (i.e., the human chromosomes 1-22) in which a trait manifests in individuals with two pathogenic alleles, either homozygotes (two copies of the same mutant allele) or compound heterozygotes (whereby each copy of a gene has a distinct mutant allele). Evidence: PCS. (PMID:26633546)
- Arthrogryposis multiplex congenita (HP:0002804): Multiple congenital contractures in different body areas. Evidence: PCS. Frequency: 3/3. (PMID:26633546)
- Atrial septal defect (HP:0001631): Atrial septal defect (ASD) is a congenital abnormality of the interatrial septum that enables blood flow between the left and right atria via the interatrial septum. Evidence: PCS. Frequency: 1/3. (PMID:26633546)
- Pulmonic stenosis (HP:0001642): A narrowing of the right ventricular outflow tract that can occur at the pulmonary valve (valvular stenosis), below the pulmonary valve (infundibular stenosis), or above the pulmonary valve (supravalvar stenosis). Evidence: PCS. Frequency: 2/3. (PMID:26633546)